- Congenital onset (HP:0003577): A phenotypic abnormality that is present at birth. Evidence: PCS. Frequency: 1/1. (PMID:28556411)
- Lateral ventricle dilatation (HP:0006956). Evidence: PCS. Frequency: 1/1. (PMID:28556411)
- Subcortical band heterotopia (HP:0032409): A form of subcortical heterotopia with mislocalized gray matter within the white matter.It is defined as longitudinal bands of gray matter located deep to the cerebral cortex and separated from it by a thin layer of normal appearing white matter. It is part of the lissencephaly spectrum. Evidence: PCS. Frequency: 4/4. (PMID:28556411;PMID:24859200)
- Seizure (HP:0001250): A seizure is an intermittent abnormality of nervous system physiology characterized by a transient occurrence of signs and/or symptoms due to abnormal excessive or synchronous neuronal activity in the brain. Evidence: PCS. Frequency: 4/5. (PMID:28556411;PMID:24859200)
- Agenesis of corpus callosum (HP:0001274): Absence of the corpus callosum as a result of the failure of the corpus callosum to develop, which can be the result of a failure in any one of the multiple steps of callosal development including cellular proliferation and migration, axonal growth or glial patterning at the midline. Evidence: PCS. Frequency: 4/4. (PMID:28556411;PMID:24859200)
- Global developmental delay (HP:0001263): A delay in the achievement of motor or mental milestones in the domains of development of a child, including motor skills, speech and language, cognitive skills, and social and emotional skills. This term should only be used to describe children younger than five years of age. Evidence: PCS. Frequency: 3/3. (PMID:24859200)
- Sleep disturbance (HP:0002360): An abnormal pattern in the quality, quantity, or characteristics of sleep. Evidence: TAS. (OMIM:600348)
- Gray matter heterotopia (HP:0002282): Heterotopia or neuronal heterotopia are macroscopic clusters of misplaced neurons (gray matter), most often situated along the ventricular walls or within the subcortical white matter. Evidence: PCS. Frequency: 1/1. (PMID:28556411)
- Profound global developmental delay (HP:0012736): A profound delay in the achievement of motor or mental milestones in the domains of development of a child. Evidence: PCS. Frequency: 1/1. (PMID:28556411)
- Severe intellectual disability (HP:0010864): Severe intellectual disability (ID) is defined as a type of ID characterized by severely sub-average adaptive functioning and intellectual functioning, with an intelligence quotient (IQ) the range of 20-34. Evidence: PCS. Frequency: 3/3. (PMID:24859200)
- Atypical behavior (HP:0000708): Atypical behavior is an abnormality in a person's actions that can be controlled or modulated by the will of the individual. While abnormal behaviors can be difficult to control, they are distinct from other abnormal actions that cannot be affected by the individual's will. Evidence: TAS. (OMIM:600348)
- Autosomal recessive inheritance (HP:0000007): A mode of inheritance that is observed for traits related to a gene encoded on one of the autosomes (i.e., the human chromosomes 1-22) in which a trait manifests in individuals with two pathogenic alleles, either homozygotes (two copies of the same mutant allele) or compound heterozygotes (whereby each copy of a gene has a distinct mutant allele). Evidence: PCS. (PMID:24859200)
- Hydrocephalus (HP:0000238): Hydrocephalus is an active distension of the ventricular system of the brain resulting from inadequate passage of CSF from its point of production within the cerebral ventricles to its point of absorption into the systemic circulation. Evidence: PCS. Frequency: 1/3. Onset: Congenital onset (HP:0003577). (PMID:24859200)
- Hydrocephalus (HP:0000238): Hydrocephalus is an active distension of the ventricular system of the brain resulting from inadequate passage of CSF from its point of production within the cerebral ventricles to its point of absorption into the systemic circulation. Evidence: PCS. Frequency: 1/1. (PMID:28556411)
- Ventriculomegaly (HP:0002119): An increase in size of the ventricular system of the brain. Evidence: PCS. Frequency: 1/3. (PMID:24859200)
- Plagiocephaly (HP:0001357): Asymmetric head shape, which is usually a combination of unilateral occipital flattening with ipsilateral frontal prominence, leading to rhomboid cranial shape. Evidence: PCS. Frequency: 1/3. (PMID:24859200)
- Macrocephaly (HP:0000256): Occipitofrontal (head) circumference greater than 97th centile compared to appropriate, age matched, sex-matched normal standards. Alternatively, a apparently increased size of the cranium. Evidence: PCS. Frequency: 3/3. (PMID:24859200)
- Spasticity (HP:0001257): A motor disorder characterized by a velocity-dependent increase in tonic stretch reflexes with increased muscle tone, exaggerated (hyperexcitable) tendon reflexes. Evidence: TAS. (OMIM:600348)
- Hypoplastic hippocampus (HP:0025517): Underdevelopment of the hippocampus. Evidence: PCS. Frequency: 1/3. (PMID:24859200)
- Polymicrogyria (HP:0002126): Polymicrogyria is a congenital malformation of the cerebral cortex characterized by abnormal cortical layering (lamination) and an excessive number of small gyri (folds). Evidence: PCS. Frequency: 4/4. (PMID:28556411;PMID:24859200)
These phenotypes are associated with the disease band heterotopia of brain (OMIM:600348).